- Weight loss (HP:0001824): Reduction of total body weight. Evidence: TAS. Frequency: Very frequent (HP:0040281). (ORPHA:103910)
- Diarrhea (HP:0002014): Abnormally increased frequency (usually defined as three or more) loose or watery bowel movements a day. Evidence: TAS. Frequency: Very frequent (HP:0040281). (ORPHA:103910)
- Protein-losing enteropathy (HP:0002243): Abnormal loss of protein from the digestive tract related to excessive leakage of plasma proteins into the lumen of the gastrointestinal tract. Evidence: TAS. Frequency: Very frequent (HP:0040281). (ORPHA:103910)
- Hypoalbuminemia (HP:0003073): The concentration of albumin in the blood circulation is below the lower limit of normal. Evidence: TAS. Frequency: Very frequent (HP:0040281). (ORPHA:103910)
- Abnormal circulating polysaccharide concentration (HP:0011012): A deviation from the normal concentration of a polysaccharide in the blood circulation. Evidence: TAS. Frequency: Very frequent (HP:0040281). (ORPHA:103910)
- Edema (HP:0000969): An abnormal accumulation of fluid beneath the skin, or in one or more cavities of the body. Evidence: TAS. Frequency: Frequent (HP:0040282). (ORPHA:103910)
- Dehydration (HP:0001944). Evidence: TAS. Frequency: Frequent (HP:0040282). (ORPHA:103910)
- Hematochezia (HP:0002573): The passage of fresh (red) blood per anus, usually in or with stools. Most rectal bleeding comes from the colon, rectum, or anus. Evidence: TAS. Frequency: Frequent (HP:0040282). (ORPHA:103910)
- Abdominal distention (HP:0003270): Distention of the abdomen. Evidence: TAS. Frequency: Frequent (HP:0040282). (ORPHA:103910)
- Abnormal circulating protein concentration (HP:0010876): An abnormal level of a circulating protein in the blood. Evidence: TAS. Frequency: Frequent (HP:0040282). (ORPHA:103910)
These phenotypes are associated with the disease Congenital enterocyte heparan sulfate deficiency (ORPHA:103910).